- Distichiasis (HP:0009743): Double rows of eyelashes. Evidence: IEA. (OMIM:126300)
- Autosomal dominant inheritance (HP:0000006): A mode of inheritance that is observed for traits related to a gene encoded on one of the autosomes (i.e., the human chromosomes 1-22) in which a trait manifests in heterozygotes. In the context of medical genetics, an autosomal dominant disorder is caused when a single copy of the mutant allele is present. Males and females are affected equally, and can both transmit the disorder with a risk of 50% for each child of inheriting the mutant allele. Evidence: IEA. (OMIM:126300)
These phenotypes are associated with the disease DISTICHIASIS (OMIM:126300).